- Decreased liver function (HP:0001410): Reduced ability of the liver to perform its functions. Evidence: TAS. Frequency: Very frequent (HP:0040281). (ORPHA:158061)
- Thrombocytopenia (HP:0001873): A reduction in the number of circulating thrombocytes. Evidence: TAS. Frequency: Very frequent (HP:0040281). (ORPHA:158061)
- Anemia (HP:0001903): A reduction in erythrocytes volume or hemoglobin concentration. Evidence: TAS. Frequency: Very frequent (HP:0040281). (ORPHA:158061)
- Fever (HP:0001945): Body temperature elevated above the normal range. Evidence: TAS. Frequency: Very frequent (HP:0040281). (ORPHA:158061)
- Autoimmunity (HP:0002960): The occurrence of an immune reaction against the organism's own cells or tissues. Evidence: TAS. Frequency: Very frequent (HP:0040281). (ORPHA:158061)
- Hypoalbuminemia (HP:0003073): The concentration of albumin in the blood circulation is below the lower limit of normal. Evidence: TAS. Frequency: Very frequent (HP:0040281). (ORPHA:158061)
- Increased circulating ferritin concentration (HP:0003281): Increased concentration of ferritin in the blood circulation. Evidence: TAS. Frequency: Very frequent (HP:0040281). (ORPHA:158061)
- Elevated erythrocyte sedimentation rate (HP:0003565): An increased erythrocyte sedimentation rate (ESR). The ESR is a test that measures the distance that erythrocytes have fallen after one hour in a vertical column of anticoagulated blood under the influence of gravity. The ESR is a nonspecific finding. An elevation may indicate inflammation or may be caused by any condition that elevates fibrinogen. Evidence: TAS. Frequency: Very frequent (HP:0040281). (ORPHA:158061)
- Abnormal circulating interleukin concentration (HP:0011117): The concentration of an interleukin (a class of cytokines) is outside the limits of normal. Evidence: TAS. Frequency: Very frequent (HP:0040281). (ORPHA:158061)
- Abnormality of tumor necrosis factor secretion (HP:0011118): An abnormality in the production or cellular release of tumor necrosis factor. Evidence: TAS. Frequency: Very frequent (HP:0040281). (ORPHA:158061)
- Hemophagocytosis (HP:0012156): Phagocytosis by macrophages of erythrocytes, leukocytes, platelets, and their precursors in bone marrow and other tissues. Evidence: TAS. Frequency: Very frequent (HP:0040281). (ORPHA:158061)
- Increased inflammatory response (HP:0012649): A abnormal increase in the inflammatory response to injury or infection. Evidence: TAS. Frequency: Very frequent (HP:0040281). (ORPHA:158061)
- Increased circulating lactate dehydrogenase concentration (HP:0025435): An elevated level of the enzyme lactate dehydrogenase in the blood circulation. Evidence: TAS. Frequency: Very frequent (HP:0040281). (ORPHA:158061)
- Increased circulating interferon-gamma concentration (HP:0030356): An elevation in the concentration of interferon gamma measured in the blood circulation. Evidence: TAS. Frequency: Very frequent (HP:0040281). (ORPHA:158061)
- Increased circulating interleukin 6 concentration (HP:0030783): The concentration of interleukin-6 in the blood circulation is above the upper limit of normal. Evidence: TAS. Frequency: Very frequent (HP:0040281). (ORPHA:158061)
- Elevated circulating alanine aminotransferase concentration (HP:0031964): An abnormally high concentration in the circulation of alanine aminotransferase (ALT). Evidence: TAS. Frequency: Very frequent (HP:0040281). (ORPHA:158061)
- Abnormal total natural killer cell count (HP:0040089): Abnormal increase or decrease of total natural killer (NK) cells, commonly characterized as CD3-CD19- and CD16+ or CD56+ lymphocytes, in the blood, per microlitre, or altered NK cell phenotype, compared to a reference range for a given sex and age-group, measured ex vivo. Evidence: TAS. Frequency: Very frequent (HP:0040281). (ORPHA:158061)
- Splenomegaly (HP:0001744): Abnormal increased size of the spleen. Evidence: TAS. Frequency: Frequent (HP:0040282). (ORPHA:158061)
- Decreased total neutrophil count (HP:0001875): Abnormal decrease of absolute number of neutrophils in the blood, per microlitre, compared to a reference range for a given sex and age-group. Evidence: TAS. Frequency: Frequent (HP:0040282). (ORPHA:158061)
- Hypertriglyceridemia (HP:0002155): An abnormal increase in the level of triglycerides in the blood. Evidence: TAS. Frequency: Frequent (HP:0040282). (ORPHA:158061)
- Lymphadenopathy (HP:0002716): Enlargement (swelling) of a lymph node. Evidence: TAS. Frequency: Frequent (HP:0040282). (ORPHA:158061)
- Juvenile rheumatoid arthritis (HP:0005681). Evidence: TAS. Frequency: Frequent (HP:0040282). (ORPHA:158061)
- Elevated circulating C-reactive protein concentration (HP:0011227): The concentration of C-reactive protein in the blood circulation is above the upper limit of normal. Evidence: TAS. Frequency: Frequent (HP:0040282). (ORPHA:158061)
- Hypofibrinogenemia (HP:0011900): Decreased concentration of fibrinogen in the blood. Evidence: TAS. Frequency: Frequent (HP:0040282). (ORPHA:158061)
- Elevated circulating aspartate aminotransferase concentration (HP:0031956): The concentration of aspartate aminotransferase (AST) in the blood circulation is above the upper limit of normal. Evidence: TAS. Frequency: Frequent (HP:0040282). (ORPHA:158061)
- Encephalopathy (HP:0001298): Encephalopathy is a term that means brain disease, damage, or malfunction. In general, encephalopathy is manifested by an altered mental state. Evidence: TAS. Frequency: Occasional (HP:0040283). (ORPHA:158061)
- Hepatomegaly (HP:0002240): Abnormally increased size of the liver. Evidence: TAS. Frequency: Occasional (HP:0040283). (ORPHA:158061)
- Systemic lupus erythematosus (HP:0002725): A chronic, relapsing, inflammatory, and often febrile multisystemic disorder of connective tissue, characterized principally by involvement of the skin, joints, kidneys, and serosal membranes. Evidence: TAS. Frequency: Occasional (HP:0040283). (ORPHA:158061)
- Hepatitis (HP:0012115): Inflammation of the liver. Evidence: TAS. Frequency: Occasional (HP:0040283). (ORPHA:158061)
These phenotypes are associated with the disease Macrophage activation syndrome (ORPHA:158061).